- Short stature (HP:0004322): A height below that which is expected according to age and gender norms. Although there is no universally accepted definition of short stature, many refer to "short stature" as height more than 2 standard deviations below the mean for age and gender (or below the 3rd percentile for age and gender dependent norms). Evidence: TAS. (OMIM:615925)
- Delayed skeletal maturation (HP:0002750): A decreased rate of skeletal maturation. Delayed skeletal maturation can be diagnosed on the basis of an estimation of the bone age from radiographs of specific bones in the human body. Evidence: TAS. Frequency: Occasional (HP:0040283). (OMIM:615925)
- Autosomal recessive inheritance (HP:0000007): A mode of inheritance that is observed for traits related to a gene encoded on one of the autosomes (i.e., the human chromosomes 1-22) in which a trait manifests in individuals with two pathogenic alleles, either homozygotes (two copies of the same mutant allele) or compound heterozygotes (whereby each copy of a gene has a distinct mutant allele). Evidence: TAS. (OMIM:615925)
- Postnatal growth retardation (HP:0008897): Slow or limited growth after birth. Evidence: TAS. (OMIM:615925)
- Decreased response to growth hormone stimulation test (HP:0000824): Insufficient responses to growth hormone (GH) provocation tests. GH deficiency is defined as a serum peak GH concentration less than 10 ng/mL on provocation with a combination of at least two separate stimulation tests. Evidence: IEA. (OMIM:615925)
- Small pituitary gland (HP:0012506): An abnormally decreased size of the pituitary gland. Evidence: TAS. Frequency: Occasional (HP:0040283). (OMIM:615925)
- Autosomal dominant inheritance (HP:0000006): A mode of inheritance that is observed for traits related to a gene encoded on one of the autosomes (i.e., the human chromosomes 1-22) in which a trait manifests in heterozygotes. In the context of medical genetics, an autosomal dominant disorder is caused when a single copy of the mutant allele is present. Males and females are affected equally, and can both transmit the disorder with a risk of 50% for each child of inheriting the mutant allele. Evidence: TAS. (OMIM:615925)
These phenotypes are associated with the disease short stature due to GHSR deficiency (OMIM:615925).